- Hypospadias (HP:0000047): Abnormal position of urethral meatus on the ventral penile shaft (underside) characterized by displacement of the urethral meatus from the tip of the glans penis to the ventral surface of the penis, scrotum, or perineum. Evidence: TAS. Frequency: Occasional (HP:0040283). (ORPHA:261204)
- Cleft palate (HP:0000175): Cleft palate is a developmental defect of the palate resulting from a failure of fusion of the palatine processes and manifesting as a separation of the roof of the mouth (soft and hard palate). Evidence: TAS. Frequency: Occasional (HP:0040283). (ORPHA:261204)
- Microcephaly (HP:0000252): Head circumference below 2 standard deviations below the mean for age and gender. Evidence: TAS. Frequency: Very frequent (HP:0040281). (ORPHA:261204)
- Myopia (HP:0000545): An abnormality of refraction characterized by the ability to see objects nearby clearly, while objects in the distance appear blurry. Evidence: TAS. Frequency: Occasional (HP:0040283). (ORPHA:261204)
- Psychosis (HP:0000709): A condition characterized by changes in personality and thought patterns, often accompanied by hallucinations and delusional beliefs, is known as psychosis. Evidence: TAS. Frequency: Occasional (HP:0040283). (ORPHA:261204)
- Autism (HP:0000717): Autism is a neurodevelopmental disorder characterized by impaired social interaction and communication, and by restricted and repetitive behavior. Autism begins in childhood. It is marked by the presence of markedly abnormal or impaired development in social interaction and communication and a markedly restricted repertoire of activity and interest. Manifestations of the disorder vary greatly depending on the developmental level and chronological age of the individual (DSM-IV). Evidence: TAS. Frequency: Occasional (HP:0040283). (ORPHA:261204)
- Pectus excavatum (HP:0000767): A defect of the chest wall characterized by a depression of the sternum, giving the chest ("pectus") a caved-in ("excavatum") appearance. Evidence: TAS. Frequency: Occasional (HP:0040283). (ORPHA:261204)
- Intellectual disability (HP:0001249): The term intellectual disability or intellectual developmental disorder is used to describe significantly sub-average intellectual and adaptive functioning based on clinical assessment and as measured by individually administered, appropriately normed, standardized and validated tests of intellectual functioning and adaptive behavior, with onset during the developmental period from infancy through adolescence. Evidence: TAS. Frequency: Occasional (HP:0040283). (ORPHA:261204)
- Seizure (HP:0001250): A seizure is an intermittent abnormality of nervous system physiology characterized by a transient occurrence of signs and/or symptoms due to abnormal excessive or synchronous neuronal activity in the brain. Evidence: TAS. Frequency: Occasional (HP:0040283). (ORPHA:261204)
- Global developmental delay (HP:0001263): A delay in the achievement of motor or mental milestones in the domains of development of a child, including motor skills, speech and language, cognitive skills, and social and emotional skills. This term should only be used to describe children younger than five years of age. Evidence: TAS. Frequency: Occasional (HP:0040283). (ORPHA:261204)
- Dystonia (HP:0001332): An abnormally increased muscular tone that causes fixed abnormal postures. There is a slow, intermittent twisting motion that leads to exaggerated turning and posture of the extremities and trunk. Evidence: TAS. Frequency: Occasional (HP:0040283). (ORPHA:261204)
- Language impairment (HP:0002463): Language impairment is a deficit in comprehension or production of language that includes reduced vocabulary, limited sentence structure, or impairments in written or spoken communication. Language abilities are substantially and quantifiably below age expectations. Evidence: TAS. Frequency: Occasional (HP:0040283). (ORPHA:261204)
- Attention deficit hyperactivity disorder (HP:0007018): Attention deficit hyperactivity disorder (ADHD) manifests at age 2-3 years or by first grade at the latest. The main symptoms are distractibility, impulsivity, hyperactivity, and often trouble organizing tasks and projects, difficulty going to sleep, and social problems from being aggressive, loud, or impatient. Evidence: TAS. Frequency: Occasional (HP:0040283). (ORPHA:261204)
- Schizophrenia (HP:0100753): A mental disorder characterized by a disintegration of thought processes and emotional responsiveness. It most commonly manifests as auditory hallucinations, paranoid or bizarre delusions, or disorganized speech and thinking. It is accompanied by significant social or occupational dysfunction. The onset of symptoms typically occurs in young adulthood, with a global lifetime prevalence of about 1%. This term is not a helpful parent term to describe abnormal experiences. Evidence: TAS. Frequency: Occasional (HP:0040283). (ORPHA:261204)
These phenotypes are associated with the disease 16p11.2p12.2 microduplication syndrome (ORPHA:261204).